Phenotypes associated with the disease Cardiac-valvular Ehlers-Danlos syndrome (ORPHA:230851):
- Hyperextensible skin (HP:0000974): A condition in which the skin can be stretched beyond normal, and then returns to its initial position. Evidence: TAS. Frequency: Very frequent (HP:0040281). (ORPHA:230851)
- Joint hypermobility (HP:0001382): The capability that a joint (or a group of joints) has to move, passively and/or actively, beyond normal limits along physiological axes. Evidence: TAS. Frequency: Very frequent (HP:0040281). (ORPHA:230851)
- Mitral regurgitation (HP:0001653): An abnormality of the mitral valve characterized by insufficiency or incompetence of the mitral valve resulting in retrograde leaking of blood through the mitral valve upon ventricular contraction. Evidence: TAS. Frequency: Very frequent (HP:0040281). (ORPHA:230851)
- Abnormal heart valve morphology (HP:0001654): Any structural abnormality of a cardiac valve. Evidence: TAS. Frequency: Very frequent (HP:0040281). (ORPHA:230851)
- Inguinal hernia (HP:0000023): Protrusion of the contents of the abdominal cavity through the inguinal canal. Evidence: TAS. Frequency: Frequent (HP:0040282). (ORPHA:230851)
- Strabismus (HP:0000486): A misalignment of the eyes so that the visual axes deviate from bifoveal fixation. The classification of strabismus may be based on a number of features including the relative position of the eyes, whether the deviation is latent or manifest, intermittent or constant, concomitant or otherwise and according to the age of onset and the relevance of any associated refractive error. Evidence: TAS. Frequency: Frequent (HP:0040282). (ORPHA:230851)
- Ptosis (HP:0000508): The upper eyelid margin is positioned 3 mm or more lower than usual and covers the superior portion of the iris (objective); or, the upper lid margin obscures at least part of the pupil (subjective). Evidence: TAS. Frequency: Frequent (HP:0040282). (ORPHA:230851)
- Myopia (HP:0000545): An abnormality of refraction characterized by the ability to see objects nearby clearly, while objects in the distance appear blurry. Evidence: TAS. Frequency: Frequent (HP:0040282). (ORPHA:230851)
- Dental crowding (HP:0000678): Changes in alignment of teeth in the dental arch. Evidence: TAS. Frequency: Frequent (HP:0040282). (ORPHA:230851)
- Pectus excavatum (HP:0000767): A defect of the chest wall characterized by a depression of the sternum, giving the chest ("pectus") a caved-in ("excavatum") appearance. Evidence: TAS. Frequency: Frequent (HP:0040282). (ORPHA:230851)
- Thin skin (HP:0000963): Reduction in thickness of the skin, generally associated with a loss of suppleness and elasticity of the skin. Evidence: TAS. Frequency: Frequent (HP:0040282). (ORPHA:230851)
- Bruising susceptibility (HP:0000978): An ecchymosis (bruise) refers to the skin discoloration caused by the escape of blood into the tissues from ruptured blood vessels. This term refers to an abnormally increased susceptibility to bruising. The corresponding phenotypic abnormality is generally elicited on medical history as a report of frequent ecchymoses or bruising without adequate trauma. Evidence: TAS. Frequency: Frequent (HP:0040282). (ORPHA:230851)
- Soft, doughy skin (HP:0001027): A skin texture that is unusually soft (and may feel silky), and has a malleable consistency resembling that of dough. Evidence: TAS. Frequency: Frequent (HP:0040282). (ORPHA:230851)
- Poor wound healing (HP:0001058): A reduced ability to heal cutaneous wounds. Evidence: TAS. Frequency: Frequent (HP:0040282). (ORPHA:230851)
- Atrophic scars (HP:0001075): Scars that form a depression compared to the level of the surrounding skin because of damage to the collagen, fat or other tissues below the skin. Evidence: TAS. Frequency: Frequent (HP:0040282). (ORPHA:230851)
- Joint dislocation (HP:0001373): Displacement or malalignment of joints. Evidence: TAS. Frequency: Frequent (HP:0040282). (ORPHA:230851)
- Aortic regurgitation (HP:0001659): An insufficiency of the aortic valve, leading to regurgitation (backward flow) of blood from the aorta into the left ventricle. Evidence: TAS. Frequency: Frequent (HP:0040282). (ORPHA:230851)
- Pes planus (HP:0001763): A foot where the longitudinal arch of the foot is in contact with the ground or floor when the individual is standing; or, in a patient lying supine, a foot where the arch is in contact with the surface of a flat board pressed against the sole of the foot by the examiner with a pressure similar to that expected from weight bearing; or, the height of the arch is reduced. Evidence: TAS. Frequency: Frequent (HP:0040282). (ORPHA:230851)
- Hallux valgus (HP:0001822): Lateral deviation of the great toe (i.e., in the direction of the little toe). Evidence: TAS. Frequency: Frequent (HP:0040282). (ORPHA:230851)
- Aortic root aneurysm (HP:0002616): An abnormal localized widening (dilatation) of the aortic root. Evidence: TAS. Frequency: Frequent (HP:0040282). (ORPHA:230851)
- Genu recurvatum (HP:0002816): An abnormally increased extension of the knee joint, so that the knee can bend backwards. Evidence: TAS. Frequency: Frequent (HP:0040282). (ORPHA:230851)
- Genu valgum (HP:0002857): The legs angle inward, such that the knees are close together and the ankles far apart. Evidence: TAS. Frequency: Frequent (HP:0040282). (ORPHA:230851)
- Tricuspid regurgitation (HP:0005180): Failure of the tricuspid valve to close sufficiently upon contraction of the right ventricle, causing blood to regurgitate (flow backward) into the right atrium. Evidence: TAS. Frequency: Frequent (HP:0040282). (ORPHA:230851)
- Absent phalangeal crease (HP:0006109): Absence of one or more interphalangeal creases (i.e., of the transverse lines in the skin between the phalanges of the fingers). Evidence: TAS. Frequency: Frequent (HP:0040282). (ORPHA:230851)
- Hypermobility of distal interphalangeal joints (HP:0006201). Evidence: TAS. Frequency: Frequent (HP:0040282). (ORPHA:230851)
- Long fingers (HP:0100807): The middle finger is more than 2 SD above the mean for newborns 27 to 41 weeks EGA or above the 97th centile for children from birth to 16 years of age AND the five digits retain their normal length proportions relative to each other (i.e., it is not the case that the middle finger is the only lengthened digit), or, Fingers that appear disproportionately long compared to the palm of the hand. Evidence: TAS. Frequency: Frequent (HP:0040282). (ORPHA:230851)
- High palate (HP:0000218): Height of the palate more than 2 SD above the mean (objective) or palatal height at the level of the first permanent molar more than twice the height of the teeth (subjective). Evidence: TAS. Frequency: Occasional (HP:0040283). (ORPHA:230851)
- Bulbous nose (HP:0000414): Increased volume and globular shape of the anteroinferior aspect of the nose. Evidence: TAS. Frequency: Occasional (HP:0040283). (ORPHA:230851)
- Thick eyebrow (HP:0000574): Increased density/number and/or increased diameter of eyebrow hairs. Evidence: TAS. Frequency: Occasional (HP:0040283). (ORPHA:230851)
- Seizure (HP:0001250): A seizure is an intermittent abnormality of nervous system physiology characterized by a transient occurrence of signs and/or symptoms due to abnormal excessive or synchronous neuronal activity in the brain. Evidence: TAS. Frequency: Occasional (HP:0040283). (ORPHA:230851)
- Global developmental delay (HP:0001263): A delay in the achievement of motor or mental milestones in the domains of development of a child, including motor skills, speech and language, cognitive skills, and social and emotional skills. This term should only be used to describe children younger than five years of age. Evidence: TAS. Frequency: Occasional (HP:0040283). (ORPHA:230851)
- Disproportionate tall stature (HP:0001519): A tall and slim body build with increased arm span to height ratio (>1.05) and a reduced upper-to-lower segment ratio (<0.85), i.e., unusually long arms and legs. The extremities as well as the hands and feet are unusually slim. Evidence: TAS. Frequency: Occasional (HP:0040283). (ORPHA:230851)
- Atrial septal defect (HP:0001631): Atrial septal defect (ASD) is a congenital abnormality of the interatrial septum that enables blood flow between the left and right atria via the interatrial septum. Evidence: TAS. Frequency: Occasional (HP:0040283). (ORPHA:230851)
- Mitral valve prolapse (HP:0001634): One or both of the leaflets (cusps) of the mitral valve bulges back into the left atrium upon contraction of the left ventricle. Evidence: TAS. Frequency: Occasional (HP:0040283). (ORPHA:230851)
- Left ventricular hypertrophy (HP:0001712): Enlargement or increased size of the heart left ventricle. Evidence: TAS. Frequency: Occasional (HP:0040283). (ORPHA:230851)
- Calcaneovalgus deformity (HP:0001848): This is a postural deformity in which the foot is positioned up against the tibia. The heel (calcaneus) is positioned downward (that is, the ankle is flexed upward), and the heel is turned outward (valgus). Evidence: TAS. Frequency: Occasional (HP:0040283). (ORPHA:230851)
- Sandal gap (HP:0001852): A widely spaced gap between the first toe (the great toe) and the second toe. Evidence: TAS. Frequency: Occasional (HP:0040283). (ORPHA:230851)
- Dyspnea (HP:0002094): Difficult or labored breathing. Dyspnea is a subjective feeling only the patient can rate, e.g., on a Borg scale. Evidence: TAS. Frequency: Occasional (HP:0040283). (ORPHA:230851)
- Moderate intellectual disability (HP:0002342): Moderate intellectual disability (ID) is defined as a type of ID characterized by moderately sub-average adaptive functioning and intellectual functioning, with an intelligence quotient (IQ) the range of 35-49. Evidence: TAS. Frequency: Occasional (HP:0040283). (ORPHA:230851)
- Kyphoscoliosis (HP:0002751): An abnormal curvature of the spine in both a coronal (lateral) and sagittal (back-to-front) plane. Evidence: TAS. Frequency: Occasional (HP:0040283). (ORPHA:230851)
- Thoracolumbar scoliosis (HP:0002944). Evidence: TAS. Frequency: Occasional (HP:0040283). (ORPHA:230851)
- Short stature (HP:0004322): A height below that which is expected according to age and gender norms. Although there is no universally accepted definition of short stature, many refer to "short stature" as height more than 2 standard deviations below the mean for age and gender (or below the 3rd percentile for age and gender dependent norms). Evidence: TAS. Frequency: Occasional (HP:0040283). (ORPHA:230851)
- Pulmonic regurgitation (HP:0010444): The retrograde (backwards) flow of blood through the pulmonary valve into the right ventricle during diastole. Evidence: TAS. Frequency: Occasional (HP:0040283). (ORPHA:230851)
- Fatigue (HP:0012378): A subjective feeling of tiredness characterized by a lack of energy and motivation. Evidence: TAS. Frequency: Occasional (HP:0040283). (ORPHA:230851)
- Severe conductive hearing impairment (HP:0012717): A severe form of conductive hearing impairment. Evidence: TAS. Frequency: Occasional (HP:0040283). (ORPHA:230851)
- Recurrent shoulder dislocation (HP:0031610): Shoulder dislocation occurring repeated times. Evidence: TAS. Frequency: Occasional (HP:0040283). (ORPHA:230851)
- Tendon thickening (HP:0032523): An abnormal increase in the thickness (diameter) of a tendon. Evidence: TAS. Frequency: Occasional (HP:0040283). (ORPHA:230851)
- Tendon rupture (HP:0100550): Breakage (tear) of a tendon. Evidence: TAS. Frequency: Occasional (HP:0040283). (ORPHA:230851)
- Myopic astigmatism (HP:0500041): A condition where one or both of the two principal meridians focus in the front of the retina when the eye is at rest. Evidence: TAS. Frequency: Occasional (HP:0040283). (ORPHA:230851)